Phenotypes associated with the disease mitochondrial DNA depletion syndrome 17 (OMIM:618567):
- Cerebral atrophy (HP:0002059): Atrophy (wasting, decrease in size of cells or tissue) affecting the cerebrum. Evidence: PCS. Frequency: 1/1. (PMID:28973171)
- Status epilepticus (HP:0002133): Status epilepticus is a type of prolonged seizure resulting either from the failure of the mechanisms responsible for seizure termination or from the initiation of mechanisms which lead to abnormally prolonged seizures (after time point t1). It is a condition that can have long-term consequences (after time point t2), including neuronal death, neuronal injury, and alteration of neuronal networks, depending on the type and duration of seizures. Evidence: PCS. Frequency: 1/1. (PMID:28973171)
- Hepatic failure (HP:0001399). Evidence: PCS. Frequency: 1/1. (PMID:28973171)
- Seizure (HP:0001250): A seizure is an intermittent abnormality of nervous system physiology characterized by a transient occurrence of signs and/or symptoms due to abnormal excessive or synchronous neuronal activity in the brain. Evidence: PCS. Frequency: 1/1. (PMID:28973171)
- Low plasma citrulline (HP:0003572): A decreased concentration of citrulline in the blood. Evidence: PCS. Frequency: 1/1. (PMID:28973171)
- Cerebellar atrophy (HP:0001272): Cerebellar atrophy is defined as a cerebellum with initially normal structures, in a posterior fossa with normal size, which displays enlarged fissures (interfolial spaces) in comparison to the foliae secondary to loss of tissue. Cerebellar atrophy implies irreversible loss of tissue and result from an ongoing progressive disease until a final stage is reached or a single injury, e.g. an intoxication or infectious event. Evidence: PCS. Frequency: 1/1. (PMID:28973171)
- Spastic tetraparesis (HP:0001285): Spastic weakness affecting all four limbs. Evidence: PCS. Frequency: 1/1. (PMID:28973171)
- Global developmental delay (HP:0001263): A delay in the achievement of motor or mental milestones in the domains of development of a child, including motor skills, speech and language, cognitive skills, and social and emotional skills. This term should only be used to describe children younger than five years of age. Evidence: PCS. Frequency: 1/1. (PMID:28973171)
- Chorea (HP:0002072): Chorea (Greek for 'dance') refers to widespread arrhythmic involuntary movements of a forcible, jerky and restless fashion. It is a random-appearing sequence of one or more discrete involuntary movements or movement fragments. Movements appear random because of variability in timing, duration or location. Each movement may have a distinct start and end. However, movements may be strung together and thus may appear to flow randomly from one muscle group to another. Chorea can involve the trunk, neck, face, tongue, and extremities. Evidence: PCS. Frequency: 1/1. Onset: Infantile onset (HP:0003593). (PMID:28973171)
- Epilepsia partialis continua (HP:0012847): Epilepsia partialis continua (also called Kojevnikov's or Kozhevnikov's epilepsia) is a type of focal motor status epilepticus characterized by repeated stereotyped simple motor manifestations such as jerks, typically of a limb or the face, recurring every few seconds or minutes for extended periods (days or years). Evidence: PCS. Frequency: 1/1. (PMID:28973171)
- Decreased activity of mitochondrial complex I (HP:0011923): A reduction in the activity of the mitochondrial respiratory chain complex I, which is part of the electron transport chain in mitochondria. Evidence: PCS. Frequency: 1/1. (PMID:28973171)
- Dyskinesia (HP:0100660): A movement disorder which consists of effects including diminished voluntary movements and the presence of involuntary movements. Evidence: PCS. Frequency: 1/1. Onset: Infantile onset (HP:0003593). (PMID:28973171)
- Hemiballismus (HP:0100248): Hemiballismus is a rare movement disorder that is caused primarily by damage to various areas in the basal ganglia. Hemiballismus is usually characterized by involuntary flinging motions of the extremities. The movements are often violent and have wide amplitudes of motion. They are continuous and random and can involve proximal and/or distal muscles on one side of the body, while some cases even include the facial muscles. The more a patient is active, the more the movements increase. With relaxation comes a decrease in movements. Evidence: PCS. Frequency: 1/1. Onset: Infantile onset (HP:0003593). (PMID:28973171)
- Death in childhood (HP:0003819): Death in during childhood, defined here as between the ages of 2 and 10 years. Evidence: PCS. Frequency: 1/1. (PMID:28973171)
- Hyperammonemia (HP:0001987): An increased concentration of ammonia in the blood. Evidence: PCS. Frequency: 1/1. (PMID:28973171)
- Autosomal recessive inheritance (HP:0000007): A mode of inheritance that is observed for traits related to a gene encoded on one of the autosomes (i.e., the human chromosomes 1-22) in which a trait manifests in individuals with two pathogenic alleles, either homozygotes (two copies of the same mutant allele) or compound heterozygotes (whereby each copy of a gene has a distinct mutant allele). Evidence: PCS. (PMID:28973171)
- Decreased activity of mitochondrial complex IV (HP:0008347): A reduction in the activity of the mitochondrial respiratory chain complex IV, which is part of the electron transport chain in mitochondria. Evidence: PCS. Frequency: 1/1. (PMID:28973171)
- Acidosis (HP:0001941): Abnormal acid accumulation or depletion of base. Evidence: PCS. Frequency: 1/1. (PMID:28973171)